Phenotypes associated with the disease Lathosterolosis (ORPHA:46059):
- Horseshoe kidney (HP:0000085): A connection of the right and left kidney by an isthmus of functioning renal parenchyma or fibrous tissue that crosses the midline. Evidence: TAS. Frequency: Frequent (HP:0040282). (ORPHA:46059)
- Gingival overgrowth (HP:0000212): Hyperplasia of the gingiva (that is, a thickening of the soft tissue overlying the alveolar ridge. The degree of thickening ranges from involvement of the interdental papillae alone to gingival overgrowth covering the entire tooth crown. Evidence: TAS. Frequency: Frequent (HP:0040282). (ORPHA:46059)
- High palate (HP:0000218): Height of the palate more than 2 SD above the mean (objective) or palatal height at the level of the first permanent molar more than twice the height of the teeth (subjective). Evidence: TAS. Frequency: Frequent (HP:0040282). (ORPHA:46059)
- Microcephaly (HP:0000252): Head circumference below 2 standard deviations below the mean for age and gender. Evidence: TAS. Frequency: Very frequent (HP:0040281). (ORPHA:46059)
- Epicanthus (HP:0000286): A fold of skin starting above the medial aspect of the upper eyelid and arching downward to cover, pass in front of and lateral to the medial canthus. Evidence: TAS. Frequency: Frequent (HP:0040282). (ORPHA:46059)
- Full cheeks (HP:0000293): Increased prominence or roundness of soft tissues between zygomata and mandible. Evidence: TAS. Frequency: Frequent (HP:0040282). (ORPHA:46059)
- Sloping forehead (HP:0000340): Inclination of the anterior surface of the forehead from the vertical more than two standard deviations above the mean (objective); or apparently excessive posterior sloping of the forehead in a lateral view. Evidence: TAS. Frequency: Frequent (HP:0040282). (ORPHA:46059)
- Narrow forehead (HP:0000341): Width of the forehead or distance between the frontotemporales is more than two standard deviations below the mean (objective); or apparently narrow intertemporal region (subjective). Evidence: TAS. Frequency: Frequent (HP:0040282). (ORPHA:46059)
- Long philtrum (HP:0000343): Distance between nasal base and midline upper lip vermilion border more than 2 SD above the mean. Alternatively, an apparently increased distance between nasal base and midline upper lip vermilion border. Evidence: TAS. Frequency: Frequent (HP:0040282). (ORPHA:46059)
- Micrognathia (HP:0000347): Developmental hypoplasia of the mandible. Evidence: TAS. Frequency: Frequent (HP:0040282). (ORPHA:46059)
- Hearing impairment (HP:0000365): A decreased magnitude of the sensory perception of sound. Evidence: TAS. Frequency: Frequent (HP:0040282). (ORPHA:46059)
- Bulbous nose (HP:0000414): Increased volume and globular shape of the anteroinferior aspect of the nose. Evidence: TAS. Frequency: Frequent (HP:0040282). (ORPHA:46059)
- Anteverted nares (HP:0000463): Anteriorly-facing nostrils viewed with the head in the Frankfurt horizontal and the eyes of the observer level with the eyes of the subject. This gives the appearance of an upturned nose (upturned nasal tip). Evidence: TAS. Frequency: Frequent (HP:0040282). (ORPHA:46059)
- Microcornea (HP:0000482): A congenital abnormality of the cornea in which the cornea and the anterior segment of the eye are smaller than normal. The horizontal diameter of the cornea does not reach 10 mm even in adulthood. Evidence: TAS. Frequency: Frequent (HP:0040282). (ORPHA:46059)
- Downslanted palpebral fissures (HP:0000494): The palpebral fissure inclination is more than two standard deviations below the mean. Evidence: TAS. Frequency: Frequent (HP:0040282). (ORPHA:46059)
- Ptosis (HP:0000508): The upper eyelid margin is positioned 3 mm or more lower than usual and covers the superior portion of the iris (objective); or, the upper lid margin obscures at least part of the pupil (subjective). Evidence: TAS. Frequency: Frequent (HP:0040282). (ORPHA:46059)
- Cataract (HP:0000518): A cataract is an opacity or clouding that develops in the crystalline lens of the eye or in its capsule. Evidence: TAS. Frequency: Very frequent (HP:0040281). (ORPHA:46059)
- Postaxial hand polydactyly (HP:0001162): Supernumerary digits located at the ulnar side of the hand (that is, on the side with the fifth finger). Evidence: TAS. Frequency: Frequent (HP:0040282). (ORPHA:46059)
- Seizure (HP:0001250): A seizure is an intermittent abnormality of nervous system physiology characterized by a transient occurrence of signs and/or symptoms due to abnormal excessive or synchronous neuronal activity in the brain. Evidence: TAS. Frequency: Frequent (HP:0040282). (ORPHA:46059)
- Hypotonia (HP:0001252): Hypotonia is an abnormally low muscle tone (the amount of tension or resistance to movement in a muscle). Even when relaxed, muscles have a continuous and passive partial contraction which provides some resistance to passive stretching. Hypotonia thus manifests as diminished resistance to passive stretching. Hypotonia is not the same as muscle weakness, although the two conditions can co-exist. Evidence: TAS. Frequency: Frequent (HP:0040282). (ORPHA:46059)
- Global developmental delay (HP:0001263): A delay in the achievement of motor or mental milestones in the domains of development of a child, including motor skills, speech and language, cognitive skills, and social and emotional skills. This term should only be used to describe children younger than five years of age. Evidence: TAS. Frequency: Very frequent (HP:0040281). (ORPHA:46059)
- Specific learning disability (HP:0001328): Impairment of certain skills such as reading or writing, coordination, self-control, or attention that interfere with the ability to learn. The impairment is not related to a global deficiency of intelligence. Evidence: TAS. Frequency: Very frequent (HP:0040281). (ORPHA:46059)
- Myoclonus (HP:0001336): Very brief, involuntary random muscular contractions occurring at rest, in response to sensory stimuli, or accompanying voluntary movements. Evidence: TAS. Frequency: Frequent (HP:0040282). (ORPHA:46059)
- Hepatic failure (HP:0001399). Evidence: TAS. Frequency: Frequent (HP:0040282). (ORPHA:46059)
- Intrahepatic cholestasis (HP:0001406): Impairment of bile flow due to obstruction in the small bile ducts within the liver. Evidence: TAS. Frequency: Frequent (HP:0040282). (ORPHA:46059)
- Failure to thrive (HP:0001508): Failure to thrive (FTT) refers to a child whose physical growth is substantially below the norm. Evidence: TAS. Frequency: Frequent (HP:0040282). (ORPHA:46059)
- Intrauterine growth retardation (HP:0001511): An abnormal restriction of fetal growth with fetal weight below the tenth percentile for gestational age. Evidence: TAS. Frequency: Frequent (HP:0040282). (ORPHA:46059)
- Toe syndactyly (HP:0001770): Webbing or fusion of the toes, involving soft parts only or including bone structure. Bony fusions are referred to as "bony" Syndactyly if the fusion occurs in a radio-ulnar axis. Fusions of bones of the toes in a proximo-distal axis are referred to as "Symphalangism". Evidence: TAS. Frequency: Frequent (HP:0040282). (ORPHA:46059)
- Postaxial foot polydactyly (HP:0001830): Polydactyly of the foot most commonly refers to the presence of six toes on one foot. Postaxial polydactyly affects the lateral ray and the duplication may range from a well-formed articulated digit to a rudimentary digit. Evidence: TAS. Frequency: Very frequent (HP:0040281). (ORPHA:46059)
- Thrombocytopenia (HP:0001873): A reduction in the number of circulating thrombocytes. Evidence: TAS. Frequency: Frequent (HP:0040282). (ORPHA:46059)
- Talipes (HP:0001883): A deformity of foot and ankle that has different subtypes that are talipes equinovarus, talipes equinovalgus, talipes calcaneovarus and talipes calcaneovalgus. Evidence: TAS. Frequency: Frequent (HP:0040282). (ORPHA:46059)
- Hepatomegaly (HP:0002240): Abnormally increased size of the liver. Evidence: TAS. Frequency: Frequent (HP:0040282). (ORPHA:46059)
- Chiari malformation (HP:0002308): Chiari malformation consists of a downward displacement of the cerebellar tonsils and the medulla through the foramen magnum, sometimes causing hydrocephalus as a result of obstruction of CSF outflow. Evidence: TAS. Frequency: Frequent (HP:0040282). (ORPHA:46059)
- Meningocele (HP:0002435): Protrusion of the meninges through a defect of the skull or vertebral column. Evidence: TAS. Frequency: Frequent (HP:0040282). (ORPHA:46059)
- Cerebral calcification (HP:0002514): The presence of calcium deposition within the cerebrum. Evidence: TAS. Frequency: Frequent (HP:0040282). (ORPHA:46059)
- Downturned corners of mouth (HP:0002714): A morphological abnormality of the mouth in which the angle of the mouth is downturned. The oral commissures are positioned inferior to the midline labial fissure. Evidence: TAS. Frequency: Frequent (HP:0040282). (ORPHA:46059)
- Short nose (HP:0003196): Distance from nasion to subnasale more than two standard deviations below the mean, or alternatively, an apparently decreased length from the nasal root to the nasal tip. Evidence: TAS. Frequency: Frequent (HP:0040282). (ORPHA:46059)
- Biparietal narrowing (HP:0004422): A narrowing of the biparietal diameter (i.e., of the transverse distance between the protuberances of the two parietal bones of the skull). Evidence: TAS. Frequency: Frequent (HP:0040282). (ORPHA:46059)
- Anisopoikilocytosis (HP:0004823): A type of poikilocytosis characterized by the presence in the blood of erythrocytes of varying sizes and abnormal shapes. Evidence: TAS. Frequency: Frequent (HP:0040282). (ORPHA:46059)
- Prominent metopic ridge (HP:0005487): Vertical bony ridge positioned in the midline of the forehead. Evidence: TAS. Frequency: Frequent (HP:0040282). (ORPHA:46059)
- Opacification of the corneal stroma (HP:0007759): Reduced transparency of the stroma of cornea. Evidence: TAS. Frequency: Frequent (HP:0040282). (ORPHA:46059)
- Cerebellar cortical atrophy (HP:0008278): Atrophy (wasting) of the cerebellar cortex. Evidence: TAS. Frequency: Frequent (HP:0040282). (ORPHA:46059)
- Hypoplasia of penis (HP:0008736). Evidence: TAS. Frequency: Very frequent (HP:0040281). (ORPHA:46059)
- Abnormal platelet morphology (HP:0011875): An anomaly in platelet form, ultrastructure, or intracellular organelles. Evidence: TAS. Frequency: Frequent (HP:0040282). (ORPHA:46059)
- Abnormal thoracic spine morphology (HP:0100711): An abnormality of the thoracic vertebral column. Evidence: TAS. Frequency: Frequent (HP:0040282). (ORPHA:46059)